- Anteverted nares (HP:0000463): Anteriorly-facing nostrils viewed with the head in the Frankfurt horizontal and the eyes of the observer level with the eyes of the subject. This gives the appearance of an upturned nose (upturned nasal tip). Evidence: PCS. Frequency: 1/1. (PMID:33517393)
- Short stature (HP:0004322): A height below that which is expected according to age and gender norms. Although there is no universally accepted definition of short stature, many refer to "short stature" as height more than 2 standard deviations below the mean for age and gender (or below the 3rd percentile for age and gender dependent norms). Evidence: PCS. Frequency: 1/1. (PMID:33517393)
- Deep philtrum (HP:0002002): Accentuated, prominent philtral ridges giving rise to an exaggerated groove in the midline between the nasal base and upper vermillion border. Evidence: PCS. Frequency: 1/1. (PMID:33517393)
- Infantile onset (HP:0003593): Onset of signs or symptoms of disease between 28 days to one year of life. Evidence: PCS. Frequency: 1/1. (PMID:33517393)
- Avascular necrosis (HP:0010885): A disease where there is cellular death (necrosis) of bone components due to interruption of the blood supply. Evidence: PCS. Frequency: 1/1. (PMID:33517393)
- Elevated circulating serum amyloid A concentration (HP:0033332): The concentration of serum amyloid A in the blood circulation is above the upper limit of normal. Evidence: PCS. Frequency: 1/1. (PMID:33517393)
- Prominent forehead (HP:0011220): Forward prominence of the entire forehead, due to protrusion of the frontal bone. Evidence: PCS. Frequency: 1/1. (PMID:33517393)
- Hypertelorism (HP:0000316): Interpupillary distance more than 2 SD above the mean (alternatively, the appearance of an increased interpupillary distance or widely spaced eyes). Evidence: PCS. Frequency: 1/1. (PMID:33517393)
- Hypertrichosis (HP:0000998): Hypertrichosis is increased hair growth that is abnormal in quantity or location. Evidence: PCS. Frequency: 1/1. (PMID:33517393)
- Lymphadenopathy (HP:0002716): Enlargement (swelling) of a lymph node. Evidence: PCS. Frequency: 1/1. (PMID:33517393)
- Recurrent pneumonia (HP:0006532): An increased susceptibility to pneumonia as manifested by a history of recurrent episodes of pneumonia. Evidence: PCS. Frequency: 1/1. (PMID:33517393)
- High palate (HP:0000218): Height of the palate more than 2 SD above the mean (objective) or palatal height at the level of the first permanent molar more than twice the height of the teeth (subjective). Evidence: PCS. Frequency: 1/1. (PMID:33517393)
- Macrocephaly (HP:0000256): Occipitofrontal (head) circumference greater than 97th centile compared to appropriate, age matched, sex-matched normal standards. Alternatively, a apparently increased size of the cranium. Evidence: PCS. Frequency: 1/1. (PMID:33517393)
- Posteriorly rotated ears (HP:0000358): A type of abnormal location of the ears in which the position of the ears is characterized by posterior rotation (the superior part of the ears is rotated towards the back of the head, and the inferior part of the ears towards the front). Evidence: PCS. Frequency: 1/1. (PMID:33517393)
- Downslanted palpebral fissures (HP:0000494): The palpebral fissure inclination is more than two standard deviations below the mean. Evidence: PCS. Frequency: 1/1. (PMID:33517393)
- Decreased circulating immunoglobulin concentration (HP:0004313): An abnormally decreased level of immunoglobulin in blood. Evidence: PCS. Frequency: 1/1. (PMID:33517393)
- Scoliosis (HP:0002650): The presence of an abnormal lateral curvature of the spine. Evidence: PCS. Frequency: 1/1. (PMID:33517393)
- Typified by somatic mosaicism (HP:0001442): Description of conditions in which affected individuals typically display somatic mosaicism, i.e., genetically distinct populations of somatic cells in a given organism caused by DNA mutations, epigenetic alterations of DNA, chromosomal abnormalities or the spontaneous reversion of inherited mutations. In many conditions typified by somatic mosaicism, constitutive mutation is lethal and cases are exclusively or predominantly mosaic. Evidence: PCS. (PMID:33517393)
- Asthma (HP:0002099): Asthma is characterized by increased responsiveness of the tracheobronchial tree to multiple stimuli, leading to narrowing of the air passages with resultant dyspnea, cough, and wheezing. Evidence: PCS. Frequency: 1/1. (PMID:33517393)
- Short neck (HP:0000470): Diminished length of the neck. Evidence: PCS. Frequency: 1/1. (PMID:33517393)
- Fibroma (HP:0010614): Benign tumors that are composed of fibrous or connective tissue. They can grow in all organs, arising from mesenchyme tissue. The term "fibroblastic" or "fibromatous" is used to describe tumors of the fibrous connective tissue. When the term fibroma is used without modifier, it is usually considered benign, with the term fibrosarcoma reserved for malignant tumors. Evidence: PCS. Frequency: 1/1. (PMID:33517393)
- Depressed nasal bridge (HP:0005280): Posterior positioning of the nasal root in relation to the overall facial profile for age. Evidence: PCS. Frequency: 1/1. (PMID:33517393)
- Elevated circulating C-reactive protein concentration (HP:0011227): The concentration of C-reactive protein in the blood circulation is above the upper limit of normal. Evidence: PCS. Frequency: 1/1. (PMID:33517393)
- Hypothyroidism (HP:0000821): Deficiency of thyroid hormone. Evidence: PCS. Frequency: 1/1. (PMID:33517393)
- Microcytic anemia (HP:0001935): A kind of anemia in which the volume of the red blood cells is reduced. Evidence: PCS. Frequency: 1/1. (PMID:33517393)
- Pectus carinatum (HP:0000768): A deformity of the chest caused by overgrowth of the ribs and characterized by protrusion of the sternum. Evidence: PCS. Frequency: 1/1. (PMID:33517393)
- Cubitus valgus (HP:0002967): Abnormal positioning in which the elbows are turned out. Evidence: PCS. Frequency: 1/1. (PMID:33517393)
- Mitral regurgitation (HP:0001653): An abnormality of the mitral valve characterized by insufficiency or incompetence of the mitral valve resulting in retrograde leaking of blood through the mitral valve upon ventricular contraction. Evidence: PCS. Frequency: 1/1. (PMID:33517393)
- Hepatosplenomegaly (HP:0001433): Simultaneous enlargement of the liver and spleen. Evidence: PCS. Frequency: 1/1. (PMID:33517393)
- Autosomal dominant inheritance (HP:0000006): A mode of inheritance that is observed for traits related to a gene encoded on one of the autosomes (i.e., the human chromosomes 1-22) in which a trait manifests in heterozygotes. In the context of medical genetics, an autosomal dominant disorder is caused when a single copy of the mutant allele is present. Males and females are affected equally, and can both transmit the disorder with a risk of 50% for each child of inheriting the mutant allele. Evidence: PCS. (PMID:33517393)
- Mandibular prognathia (HP:0000303): Abnormal prominence of the chin related to increased length of the mandible. Evidence: PCS. Frequency: 1/1. (PMID:33517393)
- Low-set ears (HP:0000369): Upper insertion of the ear to the scalp below an imaginary horizontal line drawn between the inner canthi of the eye and extending posteriorly to the ear. Evidence: PCS. Frequency: 1/1. (PMID:33517393)
These phenotypes are associated with the disease immunodeficiency 94 with autoinflammation and dysmorphic facies (OMIM:619750).